Phenotypes associated with the disease chromosome 9p deletion syndrome (OMIM:158170):
- Epicanthus (HP:0000286): A fold of skin starting above the medial aspect of the upper eyelid and arching downward to cover, pass in front of and lateral to the medial canthus. Evidence: IEA. (OMIM:158170)
- Trigonocephaly (HP:0000243): Wedge-shaped, or triangular head, with the apex of the triangle at the midline of the forehead and the base of the triangle at the occiput. Evidence: PCS. Frequency: 1/1. (PMID:17853473)
- Narrow mouth (HP:0000160): Distance between the commissures of the mouth more than 2 SD below the mean. Alternatively, an apparently decreased width of the oral aperture (subjective). Evidence: PCS. Frequency: 1/1. (PMID:17853473)
- Hypotonia (HP:0001252): Hypotonia is an abnormally low muscle tone (the amount of tension or resistance to movement in a muscle). Even when relaxed, muscles have a continuous and passive partial contraction which provides some resistance to passive stretching. Hypotonia thus manifests as diminished resistance to passive stretching. Hypotonia is not the same as muscle weakness, although the two conditions can co-exist. Evidence: IEA. (OMIM:158170)
- Hypertelorism (HP:0000316): Interpupillary distance more than 2 SD above the mean (alternatively, the appearance of an increased interpupillary distance or widely spaced eyes). Evidence: PCS. Frequency: 1/1. (PMID:17853473)
- Sporadic (HP:0003745): Cases of the disease in question occur without a previous family history, i.e., as isolated cases without being transmitted from a parent and without other siblings being affected. Evidence: PCS. (PMID:17853473)
- Patent ductus arteriosus (HP:0001643): In utero, the ductus arteriosus (DA) serves to divert ventricular output away from the lungs and toward the placenta by connecting the main pulmonary artery to the descending aorta. A patent ductus arteriosus (PDA) in the first 3 days of life is a physiologic shunt in healthy term and preterm newborn infants, and normally is substantially closed within about 24 hours after bith and completely closed after about three weeks. Failure of physiologcal closure is referred to a persistent or patent ductus arteriosus (PDA). Depending on the degree of left-to-right shunting, PDA can have clinical consequences. Evidence: IEA. (OMIM:158170)
- Retrognathia (HP:0000278): An abnormality in which the mandible is mislocalised posteriorly. Evidence: PCS. Frequency: 1/1. (PMID:17853473)
- Pes planus (HP:0001763): A foot where the longitudinal arch of the foot is in contact with the ground or floor when the individual is standing; or, in a patient lying supine, a foot where the arch is in contact with the surface of a flat board pressed against the sole of the foot by the examiner with a pressure similar to that expected from weight bearing; or, the height of the arch is reduced. Evidence: IEA. (OMIM:158170)
- Posteriorly rotated ears (HP:0000358): A type of abnormal location of the ears in which the position of the ears is characterized by posterior rotation (the superior part of the ears is rotated towards the back of the head, and the inferior part of the ears towards the front). Evidence: IEA. (OMIM:158170)
- Intellectual disability (HP:0001249): The term intellectual disability or intellectual developmental disorder is used to describe significantly sub-average intellectual and adaptive functioning based on clinical assessment and as measured by individually administered, appropriately normed, standardized and validated tests of intellectual functioning and adaptive behavior, with onset during the developmental period from infancy through adolescence. Evidence: PCS. Frequency: 1/1. (PMID:17853473)
- Highly arched eyebrow (HP:0002553): Increased height of the central portion of the eyebrow, forming a crescent, semicircular, or inverted U shape. Evidence: IEA. (OMIM:158170)
- Micropenis (HP:0000054): Abnormally small penis. At birth, the normal penis is about 3 cm (stretched length from pubic tubercle to tip of penis) with micropenis less than 2.0-2.5 cm. Evidence: IEA. (OMIM:158170)
- Heart murmur (HP:0030148): An extra or unusual sound heard during a heartbeat caused vibrations resulting from the flow of blood through the heart. Evidence: PCS. Frequency: 1/1. (PMID:17853473)
- Choanal atresia (HP:0000453): Absence or abnormal closure of the choana (the posterior nasal aperture). Most embryologists believe that posterior choanal atresia results from a failure of rupture between the 35th and 38th day of fetal life of the partition which separates the bucconasal or buccopharyngeal membranes. The resultant choanal atresia may be unilateral or bilateral, bony or membranous, complete or incomplete. In over 90 per cent of cases the obstruction is bony, while in the remainder it is membranous. The bony type of atresia is commonly located 1-2 mm. anterior to the posterior edge of the hard palate, and the osseous septum varies in thickness from 1 to 10 mm. In the membranous form of choanal atresia the obstruction usually occurs further posteriorly. In approximately one third of cases the atresia is bilateral. Evidence: IEA. (OMIM:158170)
- Global developmental delay (HP:0001263): A delay in the achievement of motor or mental milestones in the domains of development of a child, including motor skills, speech and language, cognitive skills, and social and emotional skills. This term should only be used to describe children younger than five years of age. Evidence: PCS. Frequency: 1/1. (PMID:17853473)
- Long toe (HP:0010511): Toes that appear disproportionately long compared to the foot. Evidence: PCS. Frequency: 1/1. (PMID:17853473)
- Midface retrusion (HP:0011800): Posterior positions and/or vertical shortening of the infraorbital and perialar regions, or increased concavity of the face and/or reduced nasolabial angle. Evidence: TAS. (OMIM:158170)
- Tapered finger (HP:0001182): The gradual reduction in girth of the finger from proximal to distal. Evidence: IEA. (OMIM:158170)
- Hallux varus (HP:0008080): Medial deviation of the great toe owing to a deformity of the great toe joint causing the hallux to deviate medially. Evidence: PCS. Frequency: 1/1. (PMID:17853473)
- High, narrow palate (HP:0002705): The presence of a high and narrow palate. Evidence: IEA. (OMIM:158170)
- Omphalocele (HP:0001539): A midline anterior incomplete closure of the abdominal wall in which there is herniation of the abdominal viscera into the base of the abdominal cord. Evidence: IEA. (OMIM:158170)
- Sandal gap (HP:0001852): A widely spaced gap between the first toe (the great toe) and the second toe. Evidence: PCS. Frequency: 1/1. (PMID:17853473)
- Hypospadias (HP:0000047): Abnormal position of urethral meatus on the ventral penile shaft (underside) characterized by displacement of the urethral meatus from the tip of the glans penis to the ventral surface of the penis, scrotum, or perineum. Evidence: IEA. (OMIM:158170)
- Low-set ears (HP:0000369): Upper insertion of the ear to the scalp below an imaginary horizontal line drawn between the inner canthi of the eye and extending posteriorly to the ear. Evidence: PCS. Frequency: 1/1. (PMID:17853473)
- Autosomal dominant inheritance (HP:0000006): A mode of inheritance that is observed for traits related to a gene encoded on one of the autosomes (i.e., the human chromosomes 1-22) in which a trait manifests in heterozygotes. In the context of medical genetics, an autosomal dominant disorder is caused when a single copy of the mutant allele is present. Males and females are affected equally, and can both transmit the disorder with a risk of 50% for each child of inheriting the mutant allele. Evidence: PCS. (PMID:17853473)
- Narrow forehead (HP:0000341): Width of the forehead or distance between the frontotemporales is more than two standard deviations below the mean (objective); or apparently narrow intertemporal region (subjective). Evidence: PCS. Frequency: 1/1. (PMID:17853473)
- Upslanted palpebral fissure (HP:0000582): The palpebral fissure inclination is more than two standard deviations above the mean for age (objective); or, the inclination of the palpebral fissure is greater than typical for age. Evidence: PCS. Frequency: 1/1. (PMID:17853473)
- Congenital onset (HP:0003577): A phenotypic abnormality that is present at birth. Evidence: PCS. Frequency: 1/1. (PMID:17853473)
- Clinodactyly of the 4th toe (HP:0011918): Bending or curvature of a fourth toe in the tibial direction (i.e., towards the big toe). Evidence: PCS. Frequency: 1/1. (PMID:17853473)
- Narrow palate (HP:0000189): Width of the palate more than 2 SD below the mean (objective) or apparently decreased palatal width (subjective). Evidence: PCS. Frequency: 1/1. (PMID:17853473)
- Long philtrum (HP:0000343): Distance between nasal base and midline upper lip vermilion border more than 2 SD above the mean. Alternatively, an apparently increased distance between nasal base and midline upper lip vermilion border. Evidence: IEA. (OMIM:158170)
- Hyperconvex nail (HP:0001795): When viewed on end (with the digit tip pointing toward the examiner's eye) the curve of the nail forms a tighter curve of convexity. Evidence: IEA. (OMIM:158170)
- Inguinal hernia (HP:0000023): Protrusion of the contents of the abdominal cavity through the inguinal canal. Evidence: IEA. (OMIM:158170)
- Deep philtrum (HP:0002002): Accentuated, prominent philtral ridges giving rise to an exaggerated groove in the midline between the nasal base and upper vermillion border. Evidence: PCS. Frequency: 1/1. (PMID:17853473)
- Anteverted nares (HP:0000463): Anteriorly-facing nostrils viewed with the head in the Frankfurt horizontal and the eyes of the observer level with the eyes of the subject. This gives the appearance of an upturned nose (upturned nasal tip). Evidence: PCS. Frequency: 1/1. (PMID:17853473)
- Fair hair (HP:0002286): A lesser degree of hair pigmentation than would otherwise be expected. Evidence: IEA. (OMIM:158170)
- Narrow nail (HP:0011313): Decreased width of nail. Evidence: PCS. Frequency: 1/1. (PMID:17853473)
- Ventricular septal defect (HP:0001629): A hole between the two bottom chambers (ventricles) of the heart. The defect is centered around the most superior aspect of the ventricular septum. Evidence: IEA. (OMIM:158170)
- Perimembranous ventricular septal defect (HP:0011682): A ventricular septal defect that is confluent with and involves the membranous septum and is bordered by an atrioventricular valve, not including the type 3 VSDs. Evidence: PCS. Frequency: 1/1. (PMID:17853473)
- Thin upper lip vermilion (HP:0000219): Height of the vermilion of the upper lip in the midline more than 2 SD below the mean. Alternatively, an apparently reduced height of the vermilion of the upper lip in the frontal view (subjective). Evidence: IEA. (OMIM:158170)
- High palate (HP:0000218): Height of the palate more than 2 SD above the mean (objective) or palatal height at the level of the first permanent molar more than twice the height of the teeth (subjective). Evidence: IEA. (OMIM:158170)
- Wide intermamillary distance (HP:0006610): A larger than usual distance between the left and right nipple. Evidence: IEA. (OMIM:158170)
- Hemangioma (HP:0001028): A hemangioma is a benign tumor characterized by blood-filled spaces lined by benign endothelial cells. A hemangioma characterized by large endothelial spaces (caverns) is called a cavernous hemangioma (in contrast to a hemangioma with small endothelial spaces, which is called capillary hemangioma). Evidence: PCS. Frequency: 1/1. (PMID:17853473)
- Clinodactyly of the 5th toe (HP:0001864): Bending or curvature of a fifth toe in the tibial direction (i.e., towards the big toe). Evidence: PCS. Frequency: 1/1. (PMID:17853473)
- Prominent antihelix (HP:0000395): The presence of an abnormally prominent antihelix. Evidence: PCS. Frequency: 1/1. (PMID:17853473)
- Wide nasal bridge (HP:0000431): Increased breadth of the nasal bridge (and with it, the nasal root). Evidence: IEA. (OMIM:158170)
- Thin vermilion border (HP:0000233): Height of the vermilion of the medial part of the lip more than 2 SD below the mean, or apparently reduced height of the vermilion of the lip in the frontal view. The vermilion is the red part of the lips (and confusingly, the vermilion itself is also often referred to as being equivalent the lips). Evidence: PCS. Frequency: 1/1. (PMID:17853473)
- Scoliosis (HP:0002650): The presence of an abnormal lateral curvature of the spine. Evidence: IEA. (OMIM:158170)
- Delayed speech and language development (HP:0000750): A degree of language development that is significantly below the norm for a child of a specified age. Evidence: PCS. Frequency: 1/1. (PMID:17853473)
- Dermatoglyphic variants (HP:0005882). Evidence: IEA. (OMIM:158170)
- Blue sclerae (HP:0000592): An abnormal bluish coloration of the sclera. Evidence: PCS. Frequency: 1/1. (PMID:17853473)
- Short neck (HP:0000470): Diminished length of the neck. Evidence: PCS. Frequency: 1/1. (PMID:17853473)
- Malar flattening (HP:0000272): Underdevelopment of the malar prominence of the jugal bone (zygomatic bone in mammals), appreciated in profile, frontal view, and/or by palpation. Evidence: IEA. (OMIM:158170)
- Narrow palpebral fissure (HP:0045025): Reduction in the vertical distance between the upper and lower eyelids. Evidence: PCS. Frequency: 1/1. (PMID:17853473)
- Depressed nasal bridge (HP:0005280): Posterior positioning of the nasal root in relation to the overall facial profile for age. Evidence: IEA. (OMIM:158170)
- Atrial septal defect (HP:0001631): Atrial septal defect (ASD) is a congenital abnormality of the interatrial septum that enables blood flow between the left and right atria via the interatrial septum. Evidence: PCS. Frequency: 1/1. (PMID:17853473)
- Myopia (HP:0000545): An abnormality of refraction characterized by the ability to see objects nearby clearly, while objects in the distance appear blurry. Evidence: IEA. (OMIM:158170)
- Micrognathia (HP:0000347): Developmental hypoplasia of the mandible. Evidence: IEA. (OMIM:158170)